Phenotypes associated with the disease Leri-Weill dyschondrosteosis (DECIPHER:58):
- Madelung deformity (HP:0003067): An anomaly related to partial closure, or failure of development of the ulnar side of the distal radial growth plate, which results in an arrest of epiphyseal growth of the medial and volar portions of the distal radius. This leads to shortening of the radius and relative overgrowth of the ulna. Evidence: IEA. (DECIPHER:58)
- Limited pronation/supination of forearm (HP:0006394): A limitation of the ability to place the forearm in a position such that the palm faces anteriorly (supination) and to place the forearm in a position such that the palm faces posteriorly (pronation). Evidence: IEA. (DECIPHER:58)
- Disproportionate short-limb short stature (HP:0008873): A type of disproportionate short stature characterized by a short limbs but an average-sized trunk. Evidence: IEA. (DECIPHER:58)
- Radial bowing (HP:0002986): A bending or abnormal curvature of the radius. Evidence: IEA. (DECIPHER:58)